- Spicular pigmentation of the retina (HP:0007737): Pigment migration into the retina in a bone-spicule configuration (resembling the nucleated cells within the lacuna of bone). Evidence: PCS. Frequency: 1/1. (PMID:24608809)
- Global developmental delay (HP:0001263): A delay in the achievement of motor or mental milestones in the domains of development of a child, including motor skills, speech and language, cognitive skills, and social and emotional skills. This term should only be used to describe children younger than five years of age. Evidence: PCS. Frequency: 5/7. (PMID:18327255)
- Autosomal recessive inheritance (HP:0000007): A mode of inheritance that is observed for traits related to a gene encoded on one of the autosomes (i.e., the human chromosomes 1-22) in which a trait manifests in individuals with two pathogenic alleles, either homozygotes (two copies of the same mutant allele) or compound heterozygotes (whereby each copy of a gene has a distinct mutant allele). Evidence: PCS. (PMID:18327255)
- Polydactyly (HP:0010442): A congenital anomaly characterized by the presence of supernumerary fingers or toes. Evidence: PCS. Frequency: 8/8. (PMID:18327255;PMID:24608809)
- Rod-cone dystrophy (HP:0000510): An inherited retinal disease subtype in which the rod photoreceptors appear to be more severely affected than the cone photoreceptors. Typical presentation is with nyctalopia (due to rod dysfunction) followed by loss of mid-peripheral field of vision, which gradually extends and leaves many patients with a small central island of vision due to the preservation of macular cones. Evidence: PCS. Frequency: 7/8. (PMID:18327255;PMID:24608809)
- Attenuation of retinal blood vessels (HP:0007843): Narrowing of the retinal blood vessels, both arterioles and venules. Evidence: PCS. Frequency: 1/1. (PMID:24608809)
- Intellectual disability (HP:0001249): The term intellectual disability or intellectual developmental disorder is used to describe significantly sub-average intellectual and adaptive functioning based on clinical assessment and as measured by individually administered, appropriately normed, standardized and validated tests of intellectual functioning and adaptive behavior, with onset during the developmental period from infancy through adolescence. Evidence: PCS. Frequency: 3/3. (PMID:18327255)
- Obesity (HP:0001513): Accumulation of substantial excess body fat. Evidence: PCS. Frequency: 8/8. (PMID:18327255;PMID:24608809)
These phenotypes are associated with the disease Bardet-Biedl syndrome 13 (OMIM:615990).